Phenotypes associated with the disease X-linked intellectual disability-Dandy-Walker malformation-basal ganglia disease-seizures syndrome (ORPHA:1568):
- Inguinal hernia (HP:0000023): Protrusion of the contents of the abdominal cavity through the inguinal canal. Evidence: TAS. Frequency: Very frequent (HP:0040281). (ORPHA:1568)
- Cryptorchidism (HP:0000028): Testis in inguinal canal. That is, absence of one or both testes from the scrotum owing to failure of the testis or testes to descend through the inguinal canal to the scrotum. Evidence: TAS. Frequency: Very frequent (HP:0040281). (ORPHA:1568)
- Macrocephaly (HP:0000256): Occipitofrontal (head) circumference greater than 97th centile compared to appropriate, age matched, sex-matched normal standards. Alternatively, a apparently increased size of the cranium. Evidence: TAS. Frequency: Very frequent (HP:0040281). (ORPHA:1568)
- Strabismus (HP:0000486): A misalignment of the eyes so that the visual axes deviate from bifoveal fixation. The classification of strabismus may be based on a number of features including the relative position of the eyes, whether the deviation is latent or manifest, intermittent or constant, concomitant or otherwise and according to the age of onset and the relevance of any associated refractive error. Evidence: TAS. Frequency: Very frequent (HP:0040281). (ORPHA:1568)
- Ventriculomegaly (HP:0002119): An increase in size of the ventricular system of the brain. Evidence: TAS. Frequency: Very frequent (HP:0040281). (ORPHA:1568)
- Cerebral cortical atrophy (HP:0002120): Atrophy of the cortex of the cerebrum. Evidence: TAS. Frequency: Very frequent (HP:0040281). (ORPHA:1568)
- Aplasia/Hypoplasia of the cerebellum (HP:0007360). Evidence: TAS. Frequency: Very frequent (HP:0040281). (ORPHA:1568)